- Male infertility (HP:0003251). Evidence: PCS. Frequency: 2/2. (PMID:37004249)
- Young adult onset (HP:0011462): Onset of disease at the age of between 16 and 40 years. Evidence: PCS. Frequency: 2/2. (PMID:37004249)
- Autosomal recessive inheritance (HP:0000007): A mode of inheritance that is observed for traits related to a gene encoded on one of the autosomes (i.e., the human chromosomes 1-22) in which a trait manifests in individuals with two pathogenic alleles, either homozygotes (two copies of the same mutant allele) or compound heterozygotes (whereby each copy of a gene has a distinct mutant allele). Evidence: PCS. (PMID:37004249)
- Ruffled acrosome (HP:6000501): An irregular wavy appearance of sperm acrosomes. Evidence: PCS. Frequency: 2/2. (PMID:37004249)
These phenotypes are associated with the disease spermatogenic failure 87 (OMIM:620500).